- Transient erythroblastopenia (HP:0005510): A transient reduction in the number of erythroblasts in the circulation. Evidence: IEA. (OMIM:227050)
- Anemia (HP:0001903): A reduction in erythrocytes volume or hemoglobin concentration. Evidence: IEA. (OMIM:227050)
- Autosomal recessive inheritance (HP:0000007): A mode of inheritance that is observed for traits related to a gene encoded on one of the autosomes (i.e., the human chromosomes 1-22) in which a trait manifests in individuals with two pathogenic alleles, either homozygotes (two copies of the same mutant allele) or compound heterozygotes (whereby each copy of a gene has a distinct mutant allele). Evidence: IEA. (OMIM:227050)
These phenotypes are associated with the disease transient erythroblastopenia of childhood (OMIM:227050).